- Multicystic kidney dysplasia (HP:0000003): Multicystic dysplasia of the kidney is characterized by multiple cysts of varying size in the kidney and the absence of a normal pelvicaliceal system. The condition is associated with ureteral or ureteropelvic atresia, and the affected kidney is nonfunctional. Evidence: TAS. Frequency: Very frequent (HP:0040281). (ORPHA:1851)
- Neonatal respiratory distress (HP:0002643): Respiratory difficulty as newborn. Evidence: TAS. Frequency: Very frequent (HP:0040281). (ORPHA:1851)
- Premature birth (HP:0001622): The birth of a baby of less than 37 weeks of gestational age. Evidence: TAS. Frequency: Frequent (HP:0040282). (ORPHA:1851)
- Abdominal distention (HP:0003270): Distention of the abdomen. Evidence: TAS. Frequency: Frequent (HP:0040282). (ORPHA:1851)
- Abdominal mass (HP:0031500): An abnormal enlargement or swelling in the abdomen. Evidence: TAS. Frequency: Frequent (HP:0040282). (ORPHA:1851)
- Cryptorchidism (HP:0000028): Testis in inguinal canal. That is, absence of one or both testes from the scrotum owing to failure of the testis or testes to descend through the inguinal canal to the scrotum. Evidence: TAS. Frequency: Occasional (HP:0040283). (ORPHA:1851)
- Vesicoureteral reflux (HP:0000076): Abnormal (retrograde) movement of urine from the bladder into ureters or kidneys related to inadequacy of the valvular mechanism at the ureterovesicular junction or other causes. Evidence: TAS. Frequency: Occasional (HP:0040283). (ORPHA:1851)
- Enlarged kidney (HP:0000105): An abnormal increase in the size of the kidney. Evidence: TAS. Frequency: Occasional (HP:0040283). (ORPHA:1851)
- Unilateral renal agenesis (HP:0000122): A unilateral form of agenesis of the kidney. Evidence: TAS. Frequency: Occasional (HP:0040283). (ORPHA:1851)
- Oligohydramnios (HP:0001562): Diminished amniotic fluid volume in pregnancy. Evidence: TAS. Frequency: Occasional (HP:0040283). (ORPHA:1851)
- Ureterocele (HP:0000070): A ureterocele is a congenital saccular dilatation of the distal segment of the ureter. Evidence: TAS. Frequency: Very rare (HP:0040284). (ORPHA:1851)
- Ureteropelvic junction obstruction (HP:0000074): Blockage of urine flow from the renal pelvis to the proximal ureter. Evidence: TAS. Frequency: Very rare (HP:0040284). (ORPHA:1851)
- Horseshoe kidney (HP:0000085): A connection of the right and left kidney by an isthmus of functioning renal parenchyma or fibrous tissue that crosses the midline. Evidence: TAS. Frequency: Very rare (HP:0040284). (ORPHA:1851)
- Hypertension (HP:0000822): The presence of chronic increased pressure in the systemic arterial system. Evidence: TAS. Frequency: Very rare (HP:0040284). (ORPHA:1851)
- Ureterovesical junction obstruction (HP:0030735): Blockage at the level of the bladder and the ureter caused by stenosis of the ureteral valves or failure of a narrow juxtavesical ureteral segment to dilate due to segmented fibrosis or localized absence of muscle. Evidence: TAS. Frequency: Very rare (HP:0040284). (ORPHA:1851)
These phenotypes are associated with the disease Multicystic dysplastic kidney (ORPHA:1851).